Phenotypes associated with the disease erythema nodosum, familial (OMIM:132990):
- Erythema nodosum (HP:0012219): An erythematous eruption commonly associated with drug reactions or infection and characterized by inflammatory nodules that are usually tender, multiple, and bilateral. Evidence: IEA. (OMIM:132990)
- Erythema (HP:0010783): Redness of the skin, caused by hyperemia of the capillaries in the lower layers of the skin. Evidence: IEA. (OMIM:132990)
- Autosomal dominant inheritance (HP:0000006): A mode of inheritance that is observed for traits related to a gene encoded on one of the autosomes (i.e., the human chromosomes 1-22) in which a trait manifests in heterozygotes. In the context of medical genetics, an autosomal dominant disorder is caused when a single copy of the mutant allele is present. Males and females are affected equally, and can both transmit the disorder with a risk of 50% for each child of inheriting the mutant allele. Evidence: IEA. (OMIM:132990)